Phenotypes associated with the disease Familial hypofibrinogenemia (ORPHA:101041):
- Gingival bleeding (HP:0000225): Hemorrhage affecting the gingiva. Evidence: TAS. Frequency: Very frequent (HP:0040281). (ORPHA:101041)
- Epistaxis (HP:0000421): Epistaxis, or nosebleed, refers to a hemorrhage localized in the nose. Evidence: TAS. Frequency: Very frequent (HP:0040281). (ORPHA:101041)
- Abnormal bleeding (HP:0001892): An abnormal susceptibility to bleeding, often referred to as a bleeding diathesis. A bleeding diathesis may be related to vascular, platelet and coagulation defects. Evidence: TAS. Frequency: Very frequent (HP:0040281). (ORPHA:101041)
- Gastrointestinal hemorrhage (HP:0002239): Hemorrhage affecting the gastrointestinal tract. Evidence: TAS. Frequency: Very frequent (HP:0040281). (ORPHA:101041)